- Chin myoclonus (HP:0012462): Involuntary and irregular twitches of the chin. Evidence: TAS. (OMIM:190100)
- Anxiety (HP:0000739): Intense feelings of nervousness, tension, or panic often arise in response to interpersonal stresses. There is worry about the negative effects of past unpleasant experiences and future negative possibilities. Individuals may feel fearful, apprehensive, or threatened by uncertainty, and they may also have fears of falling apart or losing control. Evidence: IEA. (OMIM:190100)
- Autosomal dominant inheritance (HP:0000006): A mode of inheritance that is observed for traits related to a gene encoded on one of the autosomes (i.e., the human chromosomes 1-22) in which a trait manifests in heterozygotes. In the context of medical genetics, an autosomal dominant disorder is caused when a single copy of the mutant allele is present. Males and females are affected equally, and can both transmit the disorder with a risk of 50% for each child of inheriting the mutant allele. Evidence: TAS. (OMIM:190100)
These phenotypes are associated with the disease hereditary geniospasm (OMIM:190100).